- Parkinsonism (HP:0001300): Characteristic neurologic anomaly resulting from degeneration of dopamine-generating cells in the substantia nigra, a region of the midbrain, characterized clinically by shaking, rigidity, slowness of movement and difficulty with walking and gait. Evidence: TAS. Frequency: Very frequent (HP:0040281). (ORPHA:454887)
- Myoclonus (HP:0001336): Very brief, involuntary random muscular contractions occurring at rest, in response to sensory stimuli, or accompanying voluntary movements. Evidence: TAS. Frequency: Very frequent (HP:0040281). (ORPHA:454887)
- Progressive extrapyramidal muscular rigidity (HP:0007158): A progressive degree of muscular rigidity (continuous contraction of muscles with constant resistance to passive movement). Evidence: TAS. Frequency: Very frequent (HP:0040281). (ORPHA:454887)
- Dementia (HP:0000726): A loss of global cognitive ability of sufficient amount to interfere with normal social or occupational function. Dementia represents a loss of previously present cognitive abilities, generally in adults, and can affect memory, thinking, language, judgment, and behavior. Evidence: TAS. Frequency: Frequent (HP:0040282). (ORPHA:454887)
- Frontal release signs (HP:0000743): Primitive reflexes traditionally held to be a sign of disorders that affect the frontal lobes. Evidence: TAS. Frequency: Frequent (HP:0040282). (ORPHA:454887)
- Gait disturbance (HP:0001288): The term gait disturbance can refer to any disruption of the ability to walk. Evidence: TAS. Frequency: Frequent (HP:0040282). (ORPHA:454887)
- Tremor (HP:0001337): An unintentional, oscillating to-and-fro muscle movement about a joint axis. Evidence: TAS. Frequency: Frequent (HP:0040282). (ORPHA:454887)
- Bradykinesia (HP:0002067): Bradykinesia literally means slow movement, and is used clinically to denote a slowness in the execution of movement (in contrast to hypokinesia, which is used to refer to slowness in the initiation of movement). Evidence: TAS. Frequency: Frequent (HP:0040282). (ORPHA:454887)
- Postural instability (HP:0002172): A tendency to fall or the inability to keep oneself from falling; imbalance. The retropulsion test is widely regarded as the gold standard to evaluate postural instability, Use of the retropulsion test includes a rapid balance perturbation in the backward direction, and the number of balance correcting steps (or total absence thereof) is used to rate the degree of postural instability. Healthy subjects correct such perturbations with either one or two large steps, or without taking any steps, hinging rapidly at the hips while swinging the arms forward as a counterweight. In patients with balance impairment, balance correcting steps are often too small, forcing patients to take more than two steps. Taking three or more steps is generally considered to be abnormal, and taking more than five steps is regarded as being clearly abnormal. Markedly affected patients continue to step backward without ever regaining their balance and must be caught by the examiner (this would be called true retropulsion). Even more severely affected patients fail to correct entirely, and fall backward like a pushed toy soldier, without taking any corrective steps. Evidence: TAS. Frequency: Frequent (HP:0040282). (ORPHA:454887)
- Akinesia (HP:0002304): Inability to initiate changes in activity or movement and to perform ordinary volitional movements rapidly and easily. Evidence: TAS. Frequency: Frequent (HP:0040282). (ORPHA:454887)
- Limb dystonia (HP:0002451): A type of dystonia (abnormally increased muscular tone causing fixed abnormal postures) that affects muscles of the limbs. Evidence: TAS. Frequency: Frequent (HP:0040282). (ORPHA:454887)
- Somatic sensory dysfunction (HP:0003474): An abnormality of the primary sensation that is mediated by peripheral nerves (pain, temperature, touch, vibration, joint position). The word hypoesthesia (or hypesthesia) refers to a reduction in cutaneous sensation to a specific type of testing. Evidence: TAS. Frequency: Frequent (HP:0040282). (ORPHA:454887)
- Involuntary movements (HP:0004305): Involuntary contractions of muscle leading to involuntary movements of extremities, neck, trunk, or face. Evidence: TAS. Frequency: Frequent (HP:0040282). (ORPHA:454887)
- Oromotor apraxia (HP:0007301): Oral-motor apraxia is the inability to volitionally sequence oral movements of the speech structure for nonspeech tasks in the absence of neuromuscular deficits such as paralysis or muscle weakness. Oral-motor apraxia is diagnosed when, despite intact sensory motor function an individual is unable to use these effector systems under voluntary control. Evidence: TAS. Frequency: Frequent (HP:0040282). (ORPHA:454887)
- Limb apraxia (HP:0030217): Difficulty in performing the correct execution of limbs movements in absence of motor impairment. Evidence: TAS. Frequency: Frequent (HP:0040282). (ORPHA:454887)
- Limb myoclonus (HP:0045084). Evidence: TAS. Frequency: Frequent (HP:0040282). (ORPHA:454887)
- Dystonia (HP:0001332): An abnormally increased muscular tone that causes fixed abnormal postures. There is a slow, intermittent twisting motion that leads to exaggerated turning and posture of the extremities and trunk. Evidence: TAS. Frequency: Occasional (HP:0040283). (ORPHA:454887)
- Memory impairment (HP:0002354): An impairment of memory as manifested by a reduced ability to remember things such as dates and names, and increased forgetfulness. Evidence: TAS. Frequency: Occasional (HP:0040283). (ORPHA:454887)
- Aphasia (HP:0002381): An acquired language impairment of some or all of the abilities to produce or comprehend speech and to read or write. Evidence: TAS. Frequency: Occasional (HP:0040283). (ORPHA:454887)
- Speech apraxia (HP:0011098): A type of apraxia that is characterized by difficulty or inability to execute speech movements because of problems with coordination and motor problems, leading to incorrect articulation. An increase of errors with increasing word and phrase length may occur. Evidence: TAS. Frequency: Occasional (HP:0040283). (ORPHA:454887)
- Atypical behavior (HP:0000708): Atypical behavior is an abnormality in a person's actions that can be controlled or modulated by the will of the individual. While abnormal behaviors can be difficult to control, they are distinct from other abnormal actions that cannot be affected by the individual's will. Evidence: TAS. Frequency: Very rare (HP:0040284). (ORPHA:454887)
- Abnormality of movement (HP:0100022): An abnormality of movement with a neurological basis characterized by changes in coordination and speed of voluntary movements. Evidence: TAS. Frequency: Very rare (HP:0040284). (ORPHA:454887)
These phenotypes are associated with the disease Corticobasal syndrome (ORPHA:454887).